- Diarrhea (HP:0002014): Abnormally increased frequency (usually defined as three or more) loose or watery bowel movements a day. Evidence: PCS. Frequency: 34/52. (PMID:27984003)
- Elevated erythrocyte sedimentation rate (HP:0003565): An increased erythrocyte sedimentation rate (ESR). The ESR is a test that measures the distance that erythrocytes have fallen after one hour in a vertical column of anticoagulated blood under the influence of gravity. The ESR is a nonspecific finding. An elevation may indicate inflammation or may be caused by any condition that elevates fibrinogen. Evidence: PCS. Frequency: 14/48. (PMID:27984003)
- Pleuritis (HP:0002102): Inflammation of the pleura. Evidence: PCS. (PMID:27984003)
- Oral ulcer (HP:0000155): Erosion of the mucous mebrane of the mouth with local excavation of the surface, resulting from the sloughing of inflammatory necrotic tissue. Evidence: PCS. Frequency: 14/52. (PMID:27984003)
- Asthma (HP:0002099): Asthma is characterized by increased responsiveness of the tracheobronchial tree to multiple stimuli, leading to narrowing of the air passages with resultant dyspnea, cough, and wheezing. Evidence: PCS. (PMID:27984003)
- Keratoconjunctivitis sicca (HP:0001097): Dryness of the eye related to deficiency of the tear film components (aqueous, mucin, or lipid), lid surface abnormalities, or epithelial abnormalities. Keratoconjunctivitis sicca often results in a scratchy or sandy sensation (foreign body sensation) in the eyes, and may also be associated with itching, inability to produce tears, photosensitivity, redness, pain, and difficulty in moving the eyelids. Evidence: PCS. Frequency: 9/22. (PMID:23102769)
- Arthralgia (HP:0002829): Joint pain. Evidence: PCS. (PMID:27984003)
- Inflammatory abnormality of the skin (HP:0011123): The presence of inflammation of the skin. That is, an abnormality of the skin resulting from the local accumulation of fluid, plasma proteins, and leukocytes. Evidence: PCS. Frequency: 29/32. (PMID:23102769;PMID:27984003)
- Xerostomia (HP:0000217): Dryness of the mouth due to salivary gland dysfunction. Evidence: PCS. (PMID:27984003)
- Recurrent fever (HP:0001954): Periodic (episodic or recurrent) bouts of fever. Evidence: PCS. Frequency: 48/74. (PMID:23102769;PMID:27984003)
- Non-Mendelian inheritance (HP:0001426): A mode of inheritance that depends on genetic determinants in more than one gene. Evidence: PCS. (PMID:27984003)
- Pericarditis (HP:0001701): Inflammation of the sac-like covering around the heart (pericardium). Evidence: PCS. (PMID:27984003)
- Chest pain (HP:0100749): An unpleasant sensation characterized by physical discomfort (such as pricking, throbbing, or aching) localized to the chest. Evidence: PCS. Frequency: 12/74. (PMID:23102769;PMID:27984003)
- Skin rash (HP:0000988): A red eruption of the skin. Evidence: PCS. Frequency: 49/54. (PMID:26070941)
- Ventricular hypertrophy (HP:0001714): Enlargement of the cardiac ventricular muscle tissue with increase in the width of the wall of the ventricle and loss of elasticity. Ventricular hypertrophy is clinically differentiated into left and right ventricular hypertrophy. Evidence: PCS. (PMID:27984003)
- Weight loss (HP:0001824): Reduction of total body weight. Evidence: PCS. Frequency: 35/76. (PMID:23102769;PMID:27984003)
- Uveitis (HP:0000554): Inflammation of one or all portions of the uveal tract. Evidence: PCS. Frequency: 0/22. (PMID:23102769)
- Abdominal pain (HP:0002027): An unpleasant sensation characterized by physical discomfort (such as pricking, throbbing, or aching) and perceived to originate in the abdomen. Evidence: PCS. Frequency: 34/52. (PMID:27984003)
- Kidney stone (HP:0000787): Kidney stones (calculi) are mineral concretions in the renal calyces and pelvis that are found free or attached to the renal papillae. Evidence: PCS. (PMID:27984003)
- Myalgia (HP:0003326): Pain in muscle. Evidence: PCS. Frequency: 19/54. (PMID:26070941)
- Arthritis (HP:0001369): Inflammation of a joint. Evidence: PCS. Frequency: 41/52. (PMID:27984003)
These phenotypes are associated with the disease Yao syndrome (OMIM:617321).